- Tented upper lip vermilion (HP:0010804): Triangular appearance of the oral aperture with the apex in the midpoint of the upper vermilion and the lower vermilion forming the base. Evidence: PCS. Frequency: 1/2. (PMID:30609410)
- Tethered cord (HP:0002144): During normal embryological development, the spinal cord first occupies the entire length of the vertebral column but goes on to assume a position at the level of L1 due to differential growth of the conus medullaris and the vertebral column. The filum terminale is a slender, threadlike structure that remains after the normal regression of the distal embryonic spinal cord and attaches the spinal cord to the coccyx. A tethered cord results if there is a thickened rope-like filum terminale which anchors the cord at the level of L2 or below, potentially causing neurologic signs owing to abnormal tension on the spinal cord. Evidence: PCS. Frequency: 1/2. (PMID:30609410)
- Strabismus (HP:0000486): A misalignment of the eyes so that the visual axes deviate from bifoveal fixation. The classification of strabismus may be based on a number of features including the relative position of the eyes, whether the deviation is latent or manifest, intermittent or constant, concomitant or otherwise and according to the age of onset and the relevance of any associated refractive error. Evidence: PCS. Frequency: 1/2. (PMID:30609410)
- Short stature (HP:0004322): A height below that which is expected according to age and gender norms. Although there is no universally accepted definition of short stature, many refer to "short stature" as height more than 2 standard deviations below the mean for age and gender (or below the 3rd percentile for age and gender dependent norms). Evidence: PCS. Frequency: 1/1. (PMID:30609410)
- Renal hypoplasia (HP:0000089): Hypoplasia of the kidney. Evidence: PCS. Frequency: 2/2. (PMID:30609410)
- Short nose (HP:0003196): Distance from nasion to subnasale more than two standard deviations below the mean, or alternatively, an apparently decreased length from the nasal root to the nasal tip. Evidence: PCS. Frequency: 1/2. (PMID:30609410)
- Hypotonia (HP:0001252): Hypotonia is an abnormally low muscle tone (the amount of tension or resistance to movement in a muscle). Even when relaxed, muscles have a continuous and passive partial contraction which provides some resistance to passive stretching. Hypotonia thus manifests as diminished resistance to passive stretching. Hypotonia is not the same as muscle weakness, although the two conditions can co-exist. Evidence: PCS. Frequency: 1/2. (PMID:30609410)
- Nystagmus (HP:0000639): Rhythmic, involuntary oscillations of one or both eyes related to abnormality in fixation, conjugate gaze, or vestibular mechanisms. Evidence: PCS. Frequency: 1/2. (PMID:30609410)
- Buphthalmos (HP:0000557): Diffusely large eye (with megalocornea) associated with glaucoma. Evidence: PCS. Frequency: 2/4. (PMID:30609410)
- Decreased total lymphocyte count (HP:0001888): A reduced number of lymphocytes in the blood. Evidence: PCS. Frequency: 1/2. (PMID:30609410)
- Corneal scarring (HP:0000559). Evidence: PCS. Frequency: 1/2. (PMID:30609410)
- Trichiasis (HP:0001128): Inversion and rubbing of the eyelashes against the globe of the eye. Evidence: PCS. Frequency: 1/2. (PMID:30609410)
- Highly arched eyebrow (HP:0002553): Increased height of the central portion of the eyebrow, forming a crescent, semicircular, or inverted U shape. Evidence: PCS. Frequency: 1/2. (PMID:30609410)
- Microcephaly (HP:0000252): Head circumference below 2 standard deviations below the mean for age and gender. Evidence: PCS. Frequency: 2/2. (PMID:30609410)
- Absent speech (HP:0001344): Complete lack of development of speech and language abilities. Evidence: PCS. Frequency: 1/2. (PMID:30609410)
- Patent ductus arteriosus after premature birth (HP:0011649): Abnormal persistent patency of the ductus arteriosus when birth was at less than 37 weeks completed gestation. Evidence: PCS. Frequency: 1/2. (PMID:30609410)
- Feeding difficulties (HP:0011968): Impaired ability to eat related to problems gathering food and getting ready to suck, chew, or swallow it. Evidence: IEA. (OMIM:618460)
- Global developmental delay (HP:0001263): A delay in the achievement of motor or mental milestones in the domains of development of a child, including motor skills, speech and language, cognitive skills, and social and emotional skills. This term should only be used to describe children younger than five years of age. Evidence: PCS. Frequency: 1/2. (PMID:30609410)
- Tricuspid regurgitation (HP:0005180): Failure of the tricuspid valve to close sufficiently upon contraction of the right ventricle, causing blood to regurgitate (flow backward) into the right atrium. Evidence: PCS. Frequency: 1/2. (PMID:30609410)
- Postaxial polydactyly (HP:0100259): A form of polydactyly in which the extra digit or digits are localized on the side of the fifth finger or fifth toe. Evidence: PCS. Frequency: 1/2. (PMID:30609410)
- Joint contracture (HP:0034392): A limitation in the passive range of motion of a joint resulting from loss of elasticity in the periarticular tissues owing to structural changes of non-bony tissues, such as muscles, tendons, ligaments, joint capsules or skin. A contracture prevents movement of the associated body part. Evidence: PCS. Frequency: 1/2. (PMID:30609410)
- Sensorineural hearing impairment (HP:0000407): A type of hearing impairment in one or both ears related to an abnormal functionality of the cochlear nerve. Evidence: PCS. Frequency: 1/2. (PMID:30609410)
- Autosomal recessive inheritance (HP:0000007): A mode of inheritance that is observed for traits related to a gene encoded on one of the autosomes (i.e., the human chromosomes 1-22) in which a trait manifests in individuals with two pathogenic alleles, either homozygotes (two copies of the same mutant allele) or compound heterozygotes (whereby each copy of a gene has a distinct mutant allele). Evidence: PCS. (PMID:30609410)
- Triangular mouth (HP:0000207): The presence of a triangular form of the mouth. Evidence: PCS. Frequency: 1/2. (PMID:30609410)
- Sacral dimple (HP:0000960): A cutaneous indentation resulting from tethering of the skin to underlying structures (bone) of the intergluteal cleft. Evidence: PCS. Frequency: 2/2. (PMID:30609410)
- Patent foramen ovale (HP:0001655): Failure of the foramen ovale to seal postnatally, leaving a potential conduit between the left and right cardiac atria. Evidence: PCS. Frequency: 1/2. (PMID:30609410)
- Hydronephrosis (HP:0000126): Severe distention of the kidney with dilation of the renal pelvis and calices. Evidence: PCS. Frequency: 2/2. (PMID:30609410)
- Hypertonia (HP:0001276): A condition in which there is increased muscle tone so that arms or legs, for example, are stiff and difficult to move. Evidence: PCS. Frequency: 1/2. (PMID:30609410)
- Congenital onset (HP:0003577): A phenotypic abnormality that is present at birth. Evidence: PCS. Frequency: 2/2. (PMID:30609410)
- Delayed closure of the anterior fontanelle (HP:0001476): A delay in closure (ossification) of the anterior fontanelle, which generally undergoes closure around the 18th month of life. Evidence: PCS. Frequency: 1/2. (PMID:30609410)
- Pigmentary retinopathy (HP:0000580): An abnormality of the retina characterized by pigment deposition. It is typically associated with migration and proliferation of macrophages or retinal pigment epithelial cells into the retina; melanin from these cells causes the pigmentary changes. Pigmentary retinopathy is a common final pathway of many retinal conditions and is often associated with visual loss. Evidence: PCS. Frequency: 1/2. (PMID:30609410)
- Failure to thrive (HP:0001508): Failure to thrive (FTT) refers to a child whose physical growth is substantially below the norm. Evidence: PCS. Frequency: 1/2. (PMID:30609410)
- Anemia (HP:0001903): A reduction in erythrocytes volume or hemoglobin concentration. Evidence: PCS. Frequency: 1/2. (PMID:30609410)
- Ventriculomegaly (HP:0002119): An increase in size of the ventricular system of the brain. Evidence: PCS. Frequency: 1/2. (PMID:30609410)
- Peters anomaly (HP:0000659): A form of anterior segment dysgenesis in which abnormal cleavage of the anterior chamber occurs. Peters anomaly is characterized by central, paracentral, or complete corneal opacity. Evidence: PCS. Frequency: 1/2. (PMID:30609410)
- Clinodactyly (HP:0030084): An angulation of a digit at an interphalangeal joint in the plane of the palm (finger) or sole (toe). Evidence: PCS. Frequency: 1/2. (PMID:30609410)
- Cerebellar vermis hypoplasia (HP:0001320): Underdevelopment of the vermis of cerebellum. Evidence: PCS. Frequency: 1/2. (PMID:30609410)
- Vesicoureteral reflux (HP:0000076): Abnormal (retrograde) movement of urine from the bladder into ureters or kidneys related to inadequacy of the valvular mechanism at the ureterovesicular junction or other causes. Evidence: PCS. Frequency: 1/2. (PMID:30609410)
- Dysphagia (HP:0002015): Difficulty in swallowing. Evidence: PCS. Frequency: 1/2. (PMID:30609410)
- Scoliosis (HP:0002650): The presence of an abnormal lateral curvature of the spine. Evidence: PCS. Frequency: 1/2. (PMID:30609410)
- Delayed ability to walk (HP:0031936): A failure to achieve the ability to walk at an appropriate developmental stage. Most children learn to walk in a series of stages, and learn to walk short distances independently between 12 and 15 months. Evidence: PCS. Frequency: 1/2. (PMID:30609410)
- Colpocephaly (HP:0030048): Colpocephaly is an anatomic finding in the brain manifested by occipital horns that are disproportionately enlarged in comparison with other parts of the lateral ventricles. Evidence: PCS. Frequency: 1/2. (PMID:30609410)
- Ureteral duplication (HP:0000073): A developmental anomaly characterized by the presence of two, instead of one, ureter connecting a kidney to the bladder. Evidence: PCS. Frequency: 1/2. (PMID:30609410)
- Epiblepharon (HP:0011225): Redundant eyelid skin pressing the eyelashes against the cornea and/or conjunctiva. Evidence: PCS. Frequency: 1/2. (PMID:30609410)
- Sleep apnea (HP:0010535): An intermittent cessation of airflow at the mouth and nose during sleep is known as sleep apnea. Apneas that last at least 10 seconds are considered significant, but individuals with sleep apnea may experience apneas lasting from 20 seconds up to 2 or 3 minutes. Patients may have up to 15 events per hour of sleep. Evidence: PCS. Frequency: 1/2. (PMID:30609410)
- Bilateral superior vena cava with no bridging vein (HP:0011668). Evidence: PCS. Frequency: 1/2. (PMID:30609410)
- Renal cyst (HP:0000107): A fluid filled sac in the kidney. Evidence: PCS. Frequency: 1/2. (PMID:30609410)
- Visual impairment (HP:0000505): Visual impairment (or vision impairment) is vision loss (of a person) to such a degree as to qualify as an additional support need through a significant limitation of visual capability resulting from either disease, trauma, or congenital or degenerative conditions that cannot be corrected by conventional means, such as refractive correction, medication, or surgery. Evidence: PCS. Frequency: 2/2. (PMID:30609410)
- Intrauterine growth retardation (HP:0001511): An abnormal restriction of fetal growth with fetal weight below the tenth percentile for gestational age. Evidence: PCS. Frequency: 1/2. (PMID:30609410)
- Frontal bossing (HP:0002007): Bilateral bulging of the lateral frontal bone prominences with relative sparing of the midline. Evidence: PCS. Frequency: 1/2. (PMID:30609410)
- Micrognathia (HP:0000347): Developmental hypoplasia of the mandible. Evidence: PCS. Frequency: 1/2. (PMID:30609410)
- Glaucoma (HP:0000501): Glaucoma refers loss of retinal ganglion cells in a characteristic pattern of optic neuropathy usually associated with increased intraocular pressure. Evidence: PCS. Frequency: 1/2. (PMID:30609410)
- Decreased total neutrophil count (HP:0001875): Abnormal decrease of absolute number of neutrophils in the blood, per microlitre, compared to a reference range for a given sex and age-group. Evidence: PCS. Frequency: 1/2. (PMID:30609410)
These phenotypes are associated with the disease Khan-Khan-Katsanis syndrome (OMIM:618460).